- Cerebral white matter agenesis (HP:0200017): Congenital defect with failure of the development of the cerebral white matter. Evidence: IEA. (OMIM:202600)
- Autosomal recessive inheritance (HP:0000007): A mode of inheritance that is observed for traits related to a gene encoded on one of the autosomes (i.e., the human chromosomes 1-22) in which a trait manifests in individuals with two pathogenic alleles, either homozygotes (two copies of the same mutant allele) or compound heterozygotes (whereby each copy of a gene has a distinct mutant allele). Evidence: IEA. (OMIM:202600)
- Intellectual disability (HP:0001249): The term intellectual disability or intellectual developmental disorder is used to describe significantly sub-average intellectual and adaptive functioning based on clinical assessment and as measured by individually administered, appropriately normed, standardized and validated tests of intellectual functioning and adaptive behavior, with onset during the developmental period from infancy through adolescence. Evidence: IEA. (OMIM:202600)
These phenotypes are associated with the disease agenesis of cerebral white matter (OMIM:202600).